- Hyperkeratosis (HP:0000962): Hyperkeratosis is a histopathological term defining a thickened stratum corneum and may be present in many different skin conditions, with many possible overlaps. Hyperkeratosis refers to the increased thickness of the stratum corneum, the outer layer of the skin. Hyperkeratosis is subclassified as orthokeratotic or parakeratotic. Orthokeratotic hyperkeratosis refers to the thickening of the keratin layer with preserved keratinocyte maturation, while parakeratotic hyperkeratosis shows retained nuclei as a sign of delayed maturation of keratinocytes. Evidence: TAS. Frequency: Very frequent (HP:0040281). (ORPHA:1659)
- Thickened skin (HP:0001072): Laminar thickening of skin. Evidence: TAS. Frequency: Very frequent (HP:0040281). (ORPHA:1659)
- Intellectual disability (HP:0001249): The term intellectual disability or intellectual developmental disorder is used to describe significantly sub-average intellectual and adaptive functioning based on clinical assessment and as measured by individually administered, appropriately normed, standardized and validated tests of intellectual functioning and adaptive behavior, with onset during the developmental period from infancy through adolescence. Evidence: TAS. Frequency: Very frequent (HP:0040281). (ORPHA:1659)
- Diminished deep tendon reflex (HP:0001315): A reduction (hyporeflexia) or complete absence (areflexia) of the involuntary muscle contraction normally elicited by a reflex stimulus, such as tapping a deep tendon. Evidence: TAS. Frequency: Frequent (HP:0040282). (ORPHA:1659)
- Hyperreflexia (HP:0001347): Hyperreflexia is the presence of hyperactive stretch reflexes of the muscles. Evidence: TAS. Frequency: Frequent (HP:0040282). (ORPHA:1659)
- Abnormal nervous system morphology (HP:0012639): A structural anomaly of the nervous system. Evidence: TAS. Frequency: Very frequent (HP:0040281). (ORPHA:1659)
These phenotypes are associated with the disease Dermatoleukodystrophy (ORPHA:1659).